Phenotypes associated with the disease retinitis pigmentosa 66 (OMIM:615233):
- Constriction of peripheral visual field (HP:0001133): An absolute or relative decrease in retinal sensitivity extending from edge (periphery) of the visual field in a concentric pattern. The visual field is the area that is perceived simultaneously by a fixating eye. Evidence: PCS. Frequency: 2/2. (PMID:19074801)
- Spicular pigmentation of the retina (HP:0007737): Pigment migration into the retina in a bone-spicule configuration (resembling the nucleated cells within the lacuna of bone). Evidence: PCS. Frequency: 2/2. (PMID:19074801)
- Nyctalopia (HP:0000662): Inability to see well at night or in poor light. Evidence: PCS. Frequency: 1/2. Onset: Adult onset (HP:0003581). (PMID:19074801)
- Adult onset (HP:0003581): Onset of disease manifestations in adulthood, defined here as at the age of 16 years or later. Evidence: PCS. Frequency: 4/4. (PMID:19074801)
- Autosomal recessive inheritance (HP:0000007): A mode of inheritance that is observed for traits related to a gene encoded on one of the autosomes (i.e., the human chromosomes 1-22) in which a trait manifests in individuals with two pathogenic alleles, either homozygotes (two copies of the same mutant allele) or compound heterozygotes (whereby each copy of a gene has a distinct mutant allele). Evidence: PCS. (PMID:19074801)
- Reduced visual acuity (HP:0007663). Evidence: PCS. Frequency: 2/2. (PMID:19074801)
- Visual impairment (HP:0000505): Visual impairment (or vision impairment) is vision loss (of a person) to such a degree as to qualify as an additional support need through a significant limitation of visual capability resulting from either disease, trauma, or congenital or degenerative conditions that cannot be corrected by conventional means, such as refractive correction, medication, or surgery. Evidence: PCS. Frequency: 2/2. (PMID:19074801)
- Central scotoma (HP:0000603): An area of depressed vision located at the point of fixation and that interferes with central vision. Evidence: PCS. Frequency: 2/2. (PMID:19074801)
- Optic disc pallor (HP:0000543): A pale yellow discoloration of the optic disc (the area of the optic nerve head in the retina). The optic disc normally has a pinkish hue with a central yellowish depression. Evidence: PCS. Frequency: 1/2. (PMID:19074801)
- Posterior subcapsular cataract (HP:0007787): A type of cataract affecting the posterior pole of lens immediately adjacent to ('beneath') the Lens capsule. Evidence: PCS. Frequency: 2/2. (PMID:19074801)
- Rod-cone dystrophy (HP:0000510): An inherited retinal disease subtype in which the rod photoreceptors appear to be more severely affected than the cone photoreceptors. Typical presentation is with nyctalopia (due to rod dysfunction) followed by loss of mid-peripheral field of vision, which gradually extends and leaves many patients with a small central island of vision due to the preservation of macular cones. Evidence: PCS. (PMID:19074801)